Phenotypes associated with the disease hypotrichosis 2 (OMIM:146520):
- Abnormality of the dentition (HP:0000164): Any abnormality of the teeth. Evidence: PCS. Frequency: 0/34. (PMID:12754508)
- Juvenile onset (HP:0003621): Onset of signs or symptoms of disease between the age of 5 and 15 years. Evidence: PCS. Frequency: 34/34. (PMID:12754508)
- Abnormal nail morphology (HP:0001597): Abnormal structure or appearance of the nail. Evidence: PCS. Frequency: 0/34. (PMID:12754508)
- Sparse scalp hair (HP:0002209): Decreased number of hairs per unit area of skin of the scalp. Evidence: PCS. Frequency: 34/34. (PMID:12754508)
- Autosomal dominant inheritance (HP:0000006): A mode of inheritance that is observed for traits related to a gene encoded on one of the autosomes (i.e., the human chromosomes 1-22) in which a trait manifests in heterozygotes. In the context of medical genetics, an autosomal dominant disorder is caused when a single copy of the mutant allele is present. Males and females are affected equally, and can both transmit the disorder with a risk of 50% for each child of inheriting the mutant allele. Evidence: PCS. (PMID:12754508)